- Renal insufficiency (HP:0000083): A reduction in the level of performance of the kidneys in areas of function comprising the concentration of urine, removal of wastes, the maintenance of electrolyte balance, homeostasis of blood pressure, and calcium metabolism. Evidence: PCS. (PMID:17713465)
- Focal segmental glomerulosclerosis (HP:0000097): Segmental accumulation of scar tissue in individual (but not all) glomeruli. Evidence: PCS. (PMID:17713465)
- Hematuria (HP:0000790): The presence of blood in the urine. Hematuria may be gross hematuria (visible to the naked eye) or microscopic hematuria (detected by dipstick or microscopic examination of the urine). Evidence: PCS. (PMID:17713465)
- Hypertension (HP:0000822): The presence of chronic increased pressure in the systemic arterial system. Evidence: PCS. (PMID:17713465)
- Proteinuria (HP:0000093): Increased levels of protein in the urine. Evidence: PCS. (PMID:17713465)
These phenotypes are associated with the disease focal segmental glomerulosclerosis 3, susceptibility to (OMIM:607832).